Phenotypes associated with the disease asphyxiating thoracic dystrophy 2 (OMIM:611263):
- Mesomelia (HP:0003027): Shortening of the middle parts of the limbs (forearm and lower leg) in relation to the upper and terminal segments. Evidence: IEA. (OMIM:611263)
- Short foot (HP:0001773): A measured foot length that is more than 2 SD below the mean for a newborn of 27 - 41 weeks gestation, or foot that is less than the 3rd centile for individuals from birth to 16 years of age (objective). Alternatively, a foot that appears disproportionately short (subjective). Evidence: IEA. (OMIM:611263)
- Rhizomelia (HP:0008905): Disproportionate shortening of the proximal segment of limbs (i.e. the femur and humerus). Evidence: IEA. (OMIM:611263)
- Brachydactyly (HP:0001156): Digits that appear disproportionately short compared to the hand/foot. The word brachydactyly is used here to describe a series distinct patterns of shortened digits (brachydactyly types A-E). This is the sense used here. Evidence: IEA. (OMIM:611263)
- Postaxial hand polydactyly (HP:0001162): Supernumerary digits located at the ulnar side of the hand (that is, on the side with the fifth finger). Evidence: IEA. (OMIM:611263)
- Short metacarpal (HP:0010049): Diminished length of one or more metacarpal bones in relation to the others of the same hand or to the contralateral metacarpal. Evidence: IEA. (OMIM:611263)
- Autosomal recessive inheritance (HP:0000007): A mode of inheritance that is observed for traits related to a gene encoded on one of the autosomes (i.e., the human chromosomes 1-22) in which a trait manifests in individuals with two pathogenic alleles, either homozygotes (two copies of the same mutant allele) or compound heterozygotes (whereby each copy of a gene has a distinct mutant allele). Evidence: IEA. (OMIM:611263)
- Narrow chest (HP:0000774): Reduced width of the chest from side to side, associated with a reduced distance from the sternal notch to the tip of the shoulder. Evidence: IEA. (OMIM:611263)
- Broad palm (HP:0001169): For children from birth to 4 years of age the palm width is more than 2 SD above the mean; for children from 4 to 16 years of age the palm width is above the 95th centile; or, the width of the palm appears disproportionately wide for the length. Evidence: IEA. (OMIM:611263)